- Headache (HP:0002315): Cephalgia, or pain sensed in various parts of the head, not confined to the area of distribution of any nerve. Evidence: TAS. Frequency: Frequent (HP:0040282). (ORPHA:533)
- Increased CSF protein concentration (HP:0002922): Increased concentration of protein in the cerebrospinal fluid. Evidence: TAS. Frequency: Frequent (HP:0040282). (ORPHA:533)
- Myalgia (HP:0003326): Pain in muscle. Evidence: TAS. Frequency: Frequent (HP:0040282). (ORPHA:533)
- Abnormal cellular immune system morphology (HP:0010987): An abnormality of the morphology or counts of the cells that make up the immune system. Evidence: TAS. Frequency: Frequent (HP:0040282). (ORPHA:533)
- Unusual CNS infection (HP:0011450): Increased susceptibility to infections of the central nervous system, as manifested by recurrent, severe, or invasive infections involving the brain, meninges, or spinal cord. This can include infections caused by opportunistic or atypical pathogens, or common pathogens presenting with unusual severity or in anatomical locations. Evidence: TAS. Frequency: Frequent (HP:0040282). (ORPHA:533)
- Hypoglycorrhachia (HP:0011972): Abnormally low glucose concentration in the cerebrospinal fluid. Evidence: TAS. Frequency: Frequent (HP:0040282). (ORPHA:533)
- Fatigue (HP:0012378): A subjective feeling of tiredness characterized by a lack of energy and motivation. Evidence: TAS. Frequency: Frequent (HP:0040282). (ORPHA:533)
- Chills (HP:0025143): A sudden sensation of feeling cold. Evidence: TAS. Frequency: Frequent (HP:0040282). (ORPHA:533)
- Stiff neck (HP:0025258): A sensation of tightness in the neck when attempting to move it, especially after a period of inactivity. Neck stiffness often involves soreness and difficulty moving the neck, especially when trying to turn the head to the side. Evidence: TAS. Frequency: Frequent (HP:0040282). (ORPHA:533)
- Bacteremia (HP:0031864): Presence of viable bacteria in the blood. Evidence: TAS. Frequency: Frequent (HP:0040282). (ORPHA:533)
- Abnormal anterior fontanelle morphology (HP:0000236): An abnormality of the anterior fontanelle, i.e., the cranial fontanelle that is located at the intersection of the coronal and sagittal sutures. Evidence: TAS. Frequency: Occasional (HP:0040283). (ORPHA:533)
- Irritability (HP:0000737): An emotional state characterized by negative feelings of heightened frustration, annoyance, or feeling upset, often triggered by internal factors (e.g., fatigue, hunger, unfulfilled desires) or external factors (e.g., social or environmental challenges). Irritability may be unpredictable, and is accompanied by a lowered threshold for emotional reactivity and observable features (speech, facial expressions, or psychomotor activity). Evidence: TAS. Frequency: Occasional (HP:0040283). (ORPHA:533)
- Seizure (HP:0001250): A seizure is an intermittent abnormality of nervous system physiology characterized by a transient occurrence of signs and/or symptoms due to abnormal excessive or synchronous neuronal activity in the brain. Evidence: TAS. Frequency: Occasional (HP:0040283). (ORPHA:533)
- Ataxia (HP:0001251): Ataxia refers to impaired coordination of voluntary muscle movement. Cerebellar ataxia refers to ataxia due to dysfunction of the cerebellum. This causes a variety of elementary neurological deficits including asynergy (lack of coordination between muscles, limbs and joints), dysmetria (lack of ability to judge distances that can lead to under- or overshoot in grasping movements), and dysdiadochokinesia (inability to perform rapid movements requiring antagonizing muscle groups to be switched on and off repeatedly). Evidence: TAS. Frequency: Occasional (HP:0040283). (ORPHA:533)
- Hemiparesis (HP:0001269): Loss of strength in the arm, leg, and sometimes face on one side of the body. Hemiplegia refers to a complete loss of strength, whereas hemiparesis refers to an incomplete loss of strength. Evidence: TAS. Frequency: Occasional (HP:0040283). (ORPHA:533)
- Myoclonus (HP:0001336): Very brief, involuntary random muscular contractions occurring at rest, in response to sensory stimuli, or accompanying voluntary movements. Evidence: TAS. Frequency: Occasional (HP:0040283). (ORPHA:533)
- Tremor (HP:0001337): An unintentional, oscillating to-and-fro muscle movement about a joint axis. Evidence: TAS. Frequency: Occasional (HP:0040283). (ORPHA:533)
- Premature birth (HP:0001622): The birth of a baby of less than 37 weeks of gestational age. Evidence: TAS. Frequency: Occasional (HP:0040283). (ORPHA:533)
- Diarrhea (HP:0002014): Abnormally increased frequency (usually defined as three or more) loose or watery bowel movements a day. Evidence: TAS. Frequency: Occasional (HP:0040283). (ORPHA:533)
- Abdominal pain (HP:0002027): An unpleasant sensation characterized by physical discomfort (such as pricking, throbbing, or aching) and perceived to originate in the abdomen. Evidence: TAS. Frequency: Occasional (HP:0040283). (ORPHA:533)
- Immunodeficiency (HP:0002721): Failure of the immune system to protect the body adequately from infection, due to the absence or insufficiency of some component process or substance. Evidence: TAS. Frequency: Occasional (HP:0040283). (ORPHA:533)
- Arthralgia (HP:0002829): Joint pain. Evidence: TAS. Frequency: Occasional (HP:0040283). (ORPHA:533)
- Respiratory failure (HP:0002878): A severe form of respiratory insufficiency characterized by inadequate gas exchange such that the levels of oxygen or carbon dioxide cannot be maintained within normal limits. Evidence: TAS. Frequency: Occasional (HP:0040283). (ORPHA:533)
- Granulomatosis (HP:0002955): A granulomatous inflammation leading to multiple granuloma formation, which is a specific type of inflammation. A granuloma is a focal compact collection of inflammatory cells, mononuclear cells predominating, usually as a result of the persistence of a non-degradable product and of active cell mediated hypersensitivity. Evidence: TAS. Frequency: Occasional (HP:0040283). (ORPHA:533)
- Back pain (HP:0003418): An unpleasant sensation characterized by physical discomfort (such as pricking, throbbing, or aching) localized to the back. Evidence: TAS. Frequency: Occasional (HP:0040283). (ORPHA:533)
- Somatic sensory dysfunction (HP:0003474): An abnormality of the primary sensation that is mediated by peripheral nerves (pain, temperature, touch, vibration, joint position). The word hypoesthesia (or hypesthesia) refers to a reduction in cutaneous sensation to a specific type of testing. Evidence: TAS. Frequency: Occasional (HP:0040283). (ORPHA:533)
- Miscarriage (HP:0005268): A pregnancy that ends at a stage in which the fetus is incapable of surviving on its own, defined as the spontaneous loss of a fetus before the 22th week of pregnancy. Evidence: TAS. Frequency: Occasional (HP:0040283). (ORPHA:533)
- Cranial nerve paralysis (HP:0006824). Evidence: TAS. Frequency: Occasional (HP:0040283). (ORPHA:533)
- Loss of consciousness (HP:0007185): Loss of awareness of oneself or one's surroundings, involving (i) a loss of normal motor control is evident as flaccidity or stiffness, either of which can be accompanied by jerking movements, and postural control is lost so that patients fall if they are in an upright position; (ii) normal responsiveness is lost; and (iii) the patient experiences amnesia for the event. Loss of consciousness my be transitory (e.g., syncope) or prolonged. Evidence: TAS. Frequency: Occasional (HP:0040283). (ORPHA:533)
- Pyelonephritis (HP:0012330): An inflammation of the kidney involving the parenchyma of kidney, the renal pelvis and the kidney calices. Evidence: TAS. Frequency: Occasional (HP:0040283). (ORPHA:533)
- Abscess (HP:0025615): An abscess is a localized collection of purulent material surrounded by inflammation and granulation. Evidence: TAS. Frequency: Occasional (HP:0040283). (ORPHA:533)
- Brain abscess (HP:0030049): A collection of pus, immune cells, and other material in the brain. Evidence: TAS. Frequency: Occasional (HP:0040283). (ORPHA:533)
- Nuchal rigidity (HP:0031179): Resistance of the extensor muscles of the neck to being bent forwards (i.e., impaired neck flexion) as a result of muscle spasm of the extensor muscles of the neck. Nuchal rigidity is not a fixed rigidity. Nuchal rigidity has been used as a bedside test for meningism, although its sensitivity for this purpose has been debated. Evidence: TAS. Frequency: Occasional (HP:0040283). (ORPHA:533)
- Abnormality of movement (HP:0100022): An abnormality of movement with a neurological basis characterized by changes in coordination and speed of voluntary movements. Evidence: TAS. Frequency: Occasional (HP:0040283). (ORPHA:533)
- Hearing impairment (HP:0000365): A decreased magnitude of the sensory perception of sound. Evidence: TAS. Frequency: Very rare (HP:0040284). (ORPHA:533)
- Conjunctivitis (HP:0000509): Inflammation of the conjunctiva. Evidence: TAS. Frequency: Very rare (HP:0040284). (ORPHA:533)
- Visual loss (HP:0000572): Loss of visual acuity (implying that vision was better at a certain time point in life). Otherwise the term reduced visual acuity should be used (or a subclass of that). Evidence: TAS. Frequency: Very rare (HP:0040284). (ORPHA:533)
- Jaundice (HP:0000952): Yellow pigmentation of the skin due to bilirubin, which in turn is the result of increased bilirubin concentration in the bloodstream. Evidence: TAS. Frequency: Very rare (HP:0040284). (ORPHA:533)
- Cholecystitis (HP:0001082): The presence of inflammatory changes in the gallbladder. Evidence: TAS. Frequency: Very rare (HP:0040284). (ORPHA:533)
- Intellectual disability (HP:0001249): The term intellectual disability or intellectual developmental disorder is used to describe significantly sub-average intellectual and adaptive functioning based on clinical assessment and as measured by individually administered, appropriately normed, standardized and validated tests of intellectual functioning and adaptive behavior, with onset during the developmental period from infancy through adolescence. Evidence: TAS. Frequency: Very rare (HP:0040284). (ORPHA:533)
- Stroke (HP:0001297): Sudden impairment of blood flow to a part of the brain due to occlusion or rupture of an artery to the brain. Evidence: TAS. Frequency: Very rare (HP:0040284). (ORPHA:533)
- Congestive heart failure (HP:0001635): The presence of an abnormality of cardiac function that is responsible for the failure of the heart to pump blood at a rate that is commensurate with the needs of the tissues or a state in which abnormally elevated filling pressures are required for the heart to do so. Heart failure is frequently related to a defect in myocardial contraction. Evidence: TAS. Frequency: Very rare (HP:0040284). (ORPHA:533)
- Pericarditis (HP:0001701): Inflammation of the sac-like covering around the heart (pericardium). Evidence: TAS. Frequency: Very rare (HP:0040284). (ORPHA:533)
- Acute kidney injury (HP:0001919): Sudden loss of renal function, as manifested by decreased urine production, and a rise in serum creatinine or blood urea nitrogen concentration (azotemia). Evidence: TAS. Frequency: Very rare (HP:0040284). (ORPHA:533)
- Pneumonia (HP:0002090): Inflammation of any part of the lung parenchyma. Evidence: TAS. Frequency: Very rare (HP:0040284). (ORPHA:533)
- Respiratory distress (HP:0002098): Respiratory distress is objectively observable as the physical or emotional consequences from the experience of dyspnea. The physical presentation of respiratory distress is generally referred to as labored breathing, while the sensation of respiratory distress is called shortness of breath or dyspnea. Evidence: TAS. Frequency: Very rare (HP:0040284). (ORPHA:533)
- Infectious encephalitis (HP:0002383): A disorder of the brain caused by an infectious agent that presents with fever, headache, and an altered level of consciousness. There may also be focal or multifocal neurologic deficits, and focal or generalized seizure activity. Evidence: TAS. Frequency: Very rare (HP:0040284). (ORPHA:533)
- Peritonitis (HP:0002586): Inflammation of the peritoneum. Evidence: TAS. Frequency: Very rare (HP:0040284). (ORPHA:533)
- Osteomyelitis (HP:0002754): Osteomyelitis is an inflammatory process accompanied by bone destruction and caused by an infecting microorganism. Evidence: TAS. Frequency: Very rare (HP:0040284). (ORPHA:533)
- Septic arthritis (HP:0003095). Evidence: TAS. Frequency: Very rare (HP:0040284). (ORPHA:533)
- Fever (HP:0001945): Body temperature elevated above the normal range. Evidence: TAS. Frequency: Very frequent (HP:0040281). (ORPHA:533)
- Meningitis (HP:0001287): Inflammation of the meninges. Evidence: TAS. Frequency: Frequent (HP:0040282). (ORPHA:533)
- Vomiting (HP:0002013): Forceful ejection of the contents of the stomach through the mouth by means of a series of involuntary spasmic contractions. Evidence: TAS. Frequency: Frequent (HP:0040282). (ORPHA:533)
- Nausea (HP:0002018): A sensation of unease in the stomach together with an urge to vomit. Evidence: TAS. Frequency: Frequent (HP:0040282). (ORPHA:533)
- Rhabdomyolysis (HP:0003201): Breakdown of muscle fibers that leads to the release of muscle fiber contents (myoglobin) into the bloodstream. Evidence: TAS. Frequency: Very rare (HP:0040284). (ORPHA:533)
- Functional motor deficit (HP:0004302). Evidence: TAS. Frequency: Very rare (HP:0040284). (ORPHA:533)
- Disseminated intravascular coagulation (HP:0005521): Disseminated intravascular coagulation is characterized by the widespread activation of coagulation, which results in the intravascular formation of fibrin and ultimately thrombotic occlusion of small and midsize vessels. Evidence: TAS. Frequency: Very rare (HP:0040284). (ORPHA:533)
- Intermittent generalized erythematous papular rash (HP:0007432). Evidence: TAS. Frequency: Very rare (HP:0040284). (ORPHA:533)
- Hepatic granulomatosis (HP:0011955): The presence of multiple granulomas in the liver as based on pathological examination. Granulomas are small 0.5 to 2 mm collections of modified macrophages called epithelioid cells usually surrounded by lymphocytes. Evidence: TAS. Frequency: Very rare (HP:0040284). (ORPHA:533)
- Arteritis (HP:0012089): Arterial inflammation. Evidence: TAS. Frequency: Very rare (HP:0040284). (ORPHA:533)
- Abnormal brainstem MRI signal intensity (HP:0012747): A deviation from normal signal on magnetic resonance imaging (MRI) of the brainstem. Evidence: TAS. Frequency: Very rare (HP:0040284). (ORPHA:533)
- Myocarditis (HP:0012819): Inflammation of the myocardium. Evidence: TAS. Frequency: Very rare (HP:0040284). (ORPHA:533)
- Splenic abscess (HP:0025059): A circumscribed area of pus or necrotic debris in the parenchyma of the spleen. Evidence: TAS. Frequency: Very rare (HP:0040284). (ORPHA:533)
- Unusual skin infection (HP:0032162): Increased susceptibility to infection of the skin, nails, or mucous membranes, as manifested by recurrent or severe cutaneous or mucosal infection, or by skin or mucous membrane infection caused by an atypical or opportunistic organism. Evidence: TAS. Frequency: Very rare (HP:0040284). (ORPHA:533)
- Liver abscess (HP:0100523): A localized, circumscribed collection of purulent material (pus) within the liver parenchyma, typically resulting from a bacterial, parasitic, or fungal infection. Unlike hepatitis, which is often diffuse, an abscess is a focal lesion. Evidence: TAS. Frequency: Very rare (HP:0040284). (ORPHA:533)
- Endocarditis (HP:0100584): An inflammation of the endocardium, the inner layer of the heart, which usually involves the heart valves. Evidence: TAS. Frequency: Very rare (HP:0040284). (ORPHA:533)
- Sepsis (HP:0100806): Sepsis is defined as life-threatening organ dysfunction caused by a dysregulated host response to infection. Evidence: TAS. Frequency: Very rare (HP:0040284). (ORPHA:533)
- Pustule (HP:0200039): A small elevation of the skin containing cloudy or purulent material usually consisting of necrotic inflammatory cells. Evidence: TAS. Frequency: Very rare (HP:0040284). (ORPHA:533)
These phenotypes are associated with the disease Listeriosis (ORPHA:533).